Phenotypes associated with the disease Cocaine intoxication (ORPHA:90068):
- Psychosis (HP:0000709): A condition characterized by changes in personality and thought patterns, often accompanied by hallucinations and delusional beliefs, is known as psychosis. Evidence: TAS. Frequency: Frequent (HP:0040282). (ORPHA:90068)
- Agitation (HP:0000713): A state of excessive motor activity that is associated with mental distress or a feeling of substantial unease or inner tension. Distinguished from restlessness by the increased level of emotional distress and negative intensity of the experience. Agitation has a significant level of physical activity that is typically threatening to the self or others. Evidence: TAS. Frequency: Frequent (HP:0040282). (ORPHA:90068)
- Psychotic episodes (HP:0000725): Periods of time during which an individual experiences significant disturbances in their thoughts, perceptions, emotions, and behavior, resulting in a loss of touch with reality. These episodes are hallmark features of psychotic disorders such as schizophrenia, schizoaffective disorder, and certain forms of bipolar disorder. Evidence: TAS. Frequency: Frequent (HP:0040282). (ORPHA:90068)
- Hypertension (HP:0000822): The presence of chronic increased pressure in the systemic arterial system. Evidence: TAS. Frequency: Frequent (HP:0040282). (ORPHA:90068)
- Hyperhidrosis (HP:0000975): Abnormal excessive perspiration (sweating) despite the lack of appropriate stimuli like hot and humid weather. Evidence: TAS. Frequency: Frequent (HP:0040282). (ORPHA:90068)
- Tachycardia (HP:0001649): A rapid heartrate that exceeds the range of the normal resting heartrate for age. Evidence: TAS. Frequency: Frequent (HP:0040282). (ORPHA:90068)
- Fever (HP:0001945): Body temperature elevated above the normal range. Evidence: TAS. Frequency: Frequent (HP:0040282). (ORPHA:90068)
- Mydriasis (HP:0011499): Abnormal dilatation of the iris. Evidence: TAS. Frequency: Frequent (HP:0040282). (ORPHA:90068)
- Paranoia (HP:0011999): The feeling and belief that one is being targeted or is a focus of negative or untoward actions, overt or covert, from others. The affected individual expresses a concern that people are in general against the individual and are engaging in subtle behaviors to make things difficult for them. The origins of such thinking may arise from real events and become amplified over time. Paranoia may also arise in the absence of any action or interaction between the person and their environment. Evidence: TAS. Frequency: Frequent (HP:0040282). (ORPHA:90068)
- Chest pain (HP:0100749): An unpleasant sensation characterized by physical discomfort (such as pricking, throbbing, or aching) localized to the chest. Evidence: TAS. Frequency: Frequent (HP:0040282). (ORPHA:90068)
- Mania (HP:0100754): A state of abnormally elevated or irritable mood, arousal, and/or energy levels. Evidence: TAS. Frequency: Frequent (HP:0040282). (ORPHA:90068)
- Proteinuria (HP:0000093): Increased levels of protein in the urine. Evidence: TAS. Frequency: Occasional (HP:0040283). (ORPHA:90068)
- Myocardial infarction (HP:0001658): Necrosis of the myocardium caused by an obstruction of the blood supply to the heart and often associated with chest pain, shortness of breath, palpitations, and anxiety as well as characteristic EKG findings and elevation of serum markers including creatine kinase-MB fraction and troponin. Evidence: TAS. Frequency: Occasional (HP:0040283). (ORPHA:90068)
- Vomiting (HP:0002013): Forceful ejection of the contents of the stomach through the mouth by means of a series of involuntary spasmic contractions. Evidence: TAS. Frequency: Occasional (HP:0040283). (ORPHA:90068)
- Nausea (HP:0002018): A sensation of unease in the stomach together with an urge to vomit. Evidence: TAS. Frequency: Occasional (HP:0040283). (ORPHA:90068)
- Abdominal pain (HP:0002027): An unpleasant sensation characterized by physical discomfort (such as pricking, throbbing, or aching) and perceived to originate in the abdomen. Evidence: TAS. Frequency: Occasional (HP:0040283). (ORPHA:90068)
- Pneumothorax (HP:0002107): Accumulation of air in the pleural cavity leading to a partially or completely collapsed lung. Evidence: TAS. Frequency: Occasional (HP:0040283). (ORPHA:90068)
- Pulmonary infiltrates (HP:0002113). Evidence: TAS. Frequency: Occasional (HP:0040283). (ORPHA:90068)
- Tachypnea (HP:0002789): Very rapid breathing. Evidence: TAS. Frequency: Occasional (HP:0040283). (ORPHA:90068)
- Elevated circulating creatine kinase activity (HP:0003236): The activity of creatine kinase in the blood circulation is above the upper limit of normal. Evidence: TAS. Frequency: Occasional (HP:0040283). (ORPHA:90068)
- Reduced consciousness (HP:0004372): Abnormally diminished level of attention, responsiveness, or wakefulness. Evidence: TAS. Frequency: Occasional (HP:0040283). (ORPHA:90068)
- Supraventricular arrhythmia (HP:0005115): A type of arrhythmia that originates above the ventricles, whereby the electrical impulse propagates down the normal His Purkinje system similar to normal sinus rhythm. Evidence: TAS. Frequency: Occasional (HP:0040283). (ORPHA:90068)
- Vivid hallucination (HP:0006803): Perceptual experiences that are vivid, intense, and sensory in nature occur in the absence of corresponding stimuli from the external environment. Evidence: TAS. Frequency: Occasional (HP:0040283). (ORPHA:90068)
- Auditory hallucination (HP:0008765): Perception of sounds without auditory stimulus. Evidence: TAS. Frequency: Occasional (HP:0040283). (ORPHA:90068)
- Cough (HP:0012735): A sudden, audible expulsion of air from the lungs through a partially closed glottis, preceded by inhalation. Evidence: TAS. Frequency: Occasional (HP:0040283). (ORPHA:90068)
- Pneumomediastinum (HP:0025421): The presence of free air in the mediastinum. Evidence: TAS. Frequency: Occasional (HP:0040283). (ORPHA:90068)
- Increased circulating lactate dehydrogenase concentration (HP:0025435): An elevated level of the enzyme lactate dehydrogenase in the blood circulation. Evidence: TAS. Frequency: Occasional (HP:0040283). (ORPHA:90068)
- Flank pain (HP:0030157): An unpleasant sensation characterized by physical discomfort (such as pricking, throbbing, or aching) and perceived to originate in the flank. Evidence: TAS. Frequency: Occasional (HP:0040283). (ORPHA:90068)
- Wheezing (HP:0030828): A high-pitched whistling sound associated with labored breathing. Evidence: TAS. Frequency: Occasional (HP:0040283). (ORPHA:90068)
- Delirium (HP:0031258): A state of sudden and severe confusion. Evidence: TAS. Frequency: Occasional (HP:0040283). (ORPHA:90068)
- Pulmonary edema (HP:0100598): Fluid accumulation in the lungs. Evidence: TAS. Frequency: Occasional (HP:0040283). (ORPHA:90068)
- Glomerulonephritis (HP:0000099): Inflammation of the renal glomeruli. Evidence: TAS. Frequency: Very rare (HP:0040284). (ORPHA:90068)
- Delusion (HP:0000746): A delusion is a fixed false belief held despite evidence to the contrary. The term delusion broadly encompasses all false judgments that possess the following external characteristics to a significant, albeit unspecified, extent: (1) they are held with an exceptional level of conviction, accompanied by an unparalleled subjective certainty; (2) there is an inability to consider alternative experiences or compelling counter-arguments; (3) the content of the belief is impossible. Evidence: TAS. Frequency: Very rare (HP:0040284). (ORPHA:90068)
- Hematuria (HP:0000790): The presence of blood in the urine. Hematuria may be gross hematuria (visible to the naked eye) or microscopic hematuria (detected by dipstick or microscopic examination of the urine). Evidence: TAS. Frequency: Very rare (HP:0040284). (ORPHA:90068)
- Seizure (HP:0001250): A seizure is an intermittent abnormality of nervous system physiology characterized by a transient occurrence of signs and/or symptoms due to abnormal excessive or synchronous neuronal activity in the brain. Evidence: TAS. Frequency: Very rare (HP:0040284). (ORPHA:90068)
- Coma (HP:0001259): The complete absence of wakefulness and consciousness, which is evident through a lack of response to any form of external stimuli. Evidence: TAS. Frequency: Very rare (HP:0040284). (ORPHA:90068)
- Tremor (HP:0001337): An unintentional, oscillating to-and-fro muscle movement about a joint axis. Evidence: TAS. Frequency: Very rare (HP:0040284). (ORPHA:90068)
- Cerebral hemorrhage (HP:0001342): Hemorrhage into the parenchyma of the brain. Evidence: TAS. Frequency: Very rare (HP:0040284). (ORPHA:90068)
- Prolonged QT interval (HP:0001657): Increased time between the start of the Q wave and the end of the T wave as measured by the electrocardiogram (EKG). Evidence: TAS. Frequency: Very rare (HP:0040284). (ORPHA:90068)
- Acute kidney injury (HP:0001919): Sudden loss of renal function, as manifested by decreased urine production, and a rise in serum creatinine or blood urea nitrogen concentration (azotemia). Evidence: TAS. Frequency: Very rare (HP:0040284). (ORPHA:90068)
- Tubulointerstitial nephritis (HP:0001970): A form of inflammation of the kidney affecting the interstitium of the kidneys surrounding the tubules. Evidence: TAS. Frequency: Very rare (HP:0040284). (ORPHA:90068)
- Bilateral tonic-clonic seizure (HP:0002069): A bilateral tonic-clonic seizure is a seizure defined by a tonic (bilateral increased tone, lasting seconds to minutes) and then a clonic (bilateral sustained rhythmic jerking) phase. Evidence: TAS. Frequency: Very rare (HP:0040284). (ORPHA:90068)
- Respiratory distress (HP:0002098): Respiratory distress is objectively observable as the physical or emotional consequences from the experience of dyspnea. The physical presentation of respiratory distress is generally referred to as labored breathing, while the sensation of respiratory distress is called shortness of breath or dyspnea. Evidence: TAS. Frequency: Very rare (HP:0040284). (ORPHA:90068)
- Hemoptysis (HP:0002105): Coughing up (expectoration) of blood or blood-streaked sputum from the larynx, trachea, bronchi, or lungs. Evidence: TAS. Frequency: Very rare (HP:0040284). (ORPHA:90068)
- Status epilepticus (HP:0002133): Status epilepticus is a type of prolonged seizure resulting either from the failure of the mechanisms responsible for seizure termination or from the initiation of mechanisms which lead to abnormally prolonged seizures (after time point t1). It is a condition that can have long-term consequences (after time point t2), including neuronal death, neuronal injury, and alteration of neuronal networks, depending on the type and duration of seizures. Evidence: TAS. Frequency: Very rare (HP:0040284). (ORPHA:90068)
- Subarachnoid hemorrhage (HP:0002138): Hemorrhage occurring between the arachnoid mater and the pia mater. Evidence: TAS. Frequency: Very rare (HP:0040284). (ORPHA:90068)
- Ischemic stroke (HP:0002140): Acute ischemic stroke (AIS) is defined by the sudden loss of blood flow to an area of the brain with the resulting loss of neurologic function. It is caused by thrombosis or embolism that occludes a cerebral vessel supplying a specific area of the brain. During a vessel occlusion, there is a core area where damage to the brain is irreversible and an area of penumbra where the brain has lost function owing to decreased blood flow but is not irreversibly injured. Evidence: TAS. Frequency: Very rare (HP:0040284). (ORPHA:90068)
- Colitis (HP:0002583): Colitis refers to an inflammation of the colon and is often used to describe an inflammation of the large intestine (colon, cecum and rectum). Colitides may be acute and self-limited or chronic, and broadly fit into the category of digestive diseases. Evidence: TAS. Frequency: Very rare (HP:0040284). (ORPHA:90068)
- Hypotension (HP:0002615): Low Blood Pressure, vascular hypotension. Evidence: TAS. Frequency: Very rare (HP:0040284). (ORPHA:90068)
- Aortic dissection (HP:0002647): Aortic dissection refers to a tear in the intimal layer of the aorta causing a separation between the intima and the medial layers of the aorta. Evidence: TAS. Frequency: Very rare (HP:0040284). (ORPHA:90068)
- Hyperventilation (HP:0002883): Hyperventilation refers to an increased pulmonary ventilation rate that is faster than necessary for the exchange of gases. Hyperventilation can result from increased frequency of breathing, an increased tidal volume, or both, and leads to an excess intake of oxygen and the blowing off of carbon dioxide. Evidence: TAS. Frequency: Very rare (HP:0040284). (ORPHA:90068)
- Rhabdomyolysis (HP:0003201): Breakdown of muscle fibers that leads to the release of muscle fiber contents (myoglobin) into the bloodstream. Evidence: TAS. Frequency: Very rare (HP:0040284). (ORPHA:90068)
- Involuntary movements (HP:0004305): Involuntary contractions of muscle leading to involuntary movements of extremities, neck, trunk, or face. Evidence: TAS. Frequency: Very rare (HP:0040284). (ORPHA:90068)
- Ventricular arrhythmia (HP:0004308). Evidence: TAS. Frequency: Very rare (HP:0040284). (ORPHA:90068)
- Gastrointestinal infarctions (HP:0005244). Evidence: TAS. Frequency: Very rare (HP:0040284). (ORPHA:90068)
- Disseminated intravascular coagulation (HP:0005521): Disseminated intravascular coagulation is characterized by the widespread activation of coagulation, which results in the intravascular formation of fibrin and ultimately thrombotic occlusion of small and midsize vessels. Evidence: TAS. Frequency: Very rare (HP:0040284). (ORPHA:90068)
- Prolonged QRS complex (HP:0006677): Increased time for the complex comprised of the Q wave, R wave, and S wave as measured by the electrocardiogram (EKG).. In adults, normal values are 0.06 - 0.10 sec. Evidence: TAS. Frequency: Very rare (HP:0040284). (ORPHA:90068)
- Focal-onset seizure (HP:0007359): A focal-onset seizure is a type of seizure originating within networks limited to one hemisphere. They may be discretely localized or more widely distributed, and may originate in subcortical structures. Evidence: TAS. Frequency: Very rare (HP:0040284). (ORPHA:90068)
- Hypovolemia (HP:0011106): An decrease in the amount of intravascular fluid, particularly in the volume of the circulating blood. Evidence: TAS. Frequency: Very rare (HP:0040284). (ORPHA:90068)
- Atypical absence status epilepticus (HP:0011151): Atypical absence status epilepticus is a type of generalized non-convulsive status epilepticus without coma that is semiologically a prolonged atypical absence seizure. Evidence: TAS. Frequency: Very rare (HP:0040284). (ORPHA:90068)
- Bloody diarrhea (HP:0025085): Passage of many stools containing blood. Evidence: TAS. Frequency: Very rare (HP:0040284). (ORPHA:90068)
- Diffuse alveolar hemorrhage (HP:0025420): A type of of pulmonary hemorrhage that originates from the pulmonary microcirculation, including the alveolar capillaries, arterioles, and venules. It presents with hemoptysis, anemia, diffuse lung infiltration, and acute respiratory failure. The diagnosis is confirmed by the observation of the accumulation of red blood cells, fibrin, or hemosiderin-laden macrophage in the alveolar space on pathologic biopsy. Hemosiderin, a product of hemoglobin degradation, appears at least 48-72 hours after bleeding and is helpful in distinguishing diffuse alveolar hemorrhage from surgical trauma. Mild interstitial thickening, organizing pneumonia, or diffuse alveolar damage can also be seen. Evidence: TAS. Frequency: Very rare (HP:0040284). (ORPHA:90068)
- Intestinal perforation (HP:0031368): A hole (perforation) in the wall of the intestine. Evidence: TAS. Frequency: Very rare (HP:0040284). (ORPHA:90068)